- Abnormal bleeding (HP:0001892): An abnormal susceptibility to bleeding, often referred to as a bleeding diathesis. A bleeding diathesis may be related to vascular, platelet and coagulation defects. Evidence: IEA. Onset: Congenital onset (HP:0003577). (OMIM:144050)
- Autosomal dominant inheritance (HP:0000006): A mode of inheritance that is observed for traits related to a gene encoded on one of the autosomes (i.e., the human chromosomes 1-22) in which a trait manifests in heterozygotes. In the context of medical genetics, an autosomal dominant disorder is caused when a single copy of the mutant allele is present. Males and females are affected equally, and can both transmit the disorder with a risk of 50% for each child of inheriting the mutant allele. Evidence: IEA. (OMIM:144050)
These phenotypes are associated with the disease hyperheparinemia (OMIM:144050).